- Abnormality of the nervous system (HP:0000707): An abnormality of the nervous system. Evidence: IEA. (OMIM:170980)
- Autosomal dominant inheritance (HP:0000006): A mode of inheritance that is observed for traits related to a gene encoded on one of the autosomes (i.e., the human chromosomes 1-22) in which a trait manifests in heterozygotes. In the context of medical genetics, an autosomal dominant disorder is caused when a single copy of the mutant allele is present. Males and females are affected equally, and can both transmit the disorder with a risk of 50% for each child of inheriting the mutant allele. Evidence: IEA. (OMIM:170980)
These phenotypes are associated with the disease peroneal nerve, accessory deep (OMIM:170980).